Phenotypes associated with the disease Keratosis linearis-ichthyosis congenita-sclerosing keratoderma syndrome (ORPHA:281201):
- Palmoplantar keratoderma (HP:0000982): Abnormal thickening of the skin of the palms of the hands and the soles of the feet. Evidence: TAS. Frequency: Very frequent (HP:0040281). (ORPHA:281201)
- Ichthyosis (HP:0008064): An abnormality of the skin characterized the presence of excessive amounts of dry surface scales on the skin resulting from an abnormality of keratinization. Evidence: TAS. Frequency: Very frequent (HP:0040281). (ORPHA:281201)